Phenotypes associated with the disease chronic mucocutaneous candidiasis due to intrinsic defect in lymphoblastic transformation (OMIM:247450):
- Abnormality of metabolism/homeostasis (HP:0001939). Evidence: IEA. (OMIM:247450)
- Recurrent mucocutaneous candidiasis (HP:0002728): Recurrent or persistent superficial Candida infections of the skin, mucous membranes, and nails. Evidence: IEA. (OMIM:247450)
- Autosomal recessive inheritance (HP:0000007): A mode of inheritance that is observed for traits related to a gene encoded on one of the autosomes (i.e., the human chromosomes 1-22) in which a trait manifests in individuals with two pathogenic alleles, either homozygotes (two copies of the same mutant allele) or compound heterozygotes (whereby each copy of a gene has a distinct mutant allele). Evidence: IEA. (OMIM:247450)